- Bone pain (HP:0002653): An unpleasant sensation characterized by physical discomfort (such as pricking, throbbing, or aching) localized to bone. Evidence: TAS. (OMIM:112270)
- Autosomal dominant inheritance (HP:0000006): A mode of inheritance that is observed for traits related to a gene encoded on one of the autosomes (i.e., the human chromosomes 1-22) in which a trait manifests in heterozygotes. In the context of medical genetics, an autosomal dominant disorder is caused when a single copy of the mutant allele is present. Males and females are affected equally, and can both transmit the disorder with a risk of 50% for each child of inheriting the mutant allele. Evidence: IEA. (OMIM:112270)
These phenotypes are associated with the disease bone pain, periodic (OMIM:112270).